- Limitation of joint mobility (HP:0001376): A reduction in the freedom of movement of one or more joints. Evidence: TAS. Frequency: Very frequent (HP:0040281). (ORPHA:281122)
- Ichthyosis (HP:0008064): An abnormality of the skin characterized the presence of excessive amounts of dry surface scales on the skin resulting from an abnormality of keratinization. Evidence: TAS. Frequency: Very frequent (HP:0040281). (ORPHA:281122)
These phenotypes are associated with the disease Self-improving collodion baby (ORPHA:281122).